- Abnormal facial shape (HP:0001999): An abnormal morphology (form) of the face or its components. Evidence: TAS. Frequency: Very frequent (HP:0040281). (ORPHA:487796)
- Brain imaging abnormality (HP:0410263): An anomaly of metabolism or structure of the brain identified by imaging. Evidence: TAS. Frequency: Very frequent (HP:0040281). (ORPHA:487796)
- Abnormality of the genitourinary system (HP:0000119): The presence of any abnormality of the genitourinary system. Evidence: TAS. Frequency: Frequent (HP:0040282). (ORPHA:487796)
- Abnormal sternum morphology (HP:0000766): An anomaly of the sternum, also known as the breastbone. Evidence: TAS. Frequency: Frequent (HP:0040282). (ORPHA:487796)
- Abnormality of the endocrine system (HP:0000818): An abnormality of the endocrine system. Evidence: TAS. Frequency: Frequent (HP:0040282). (ORPHA:487796)
- Intellectual disability (HP:0001249): The term intellectual disability or intellectual developmental disorder is used to describe significantly sub-average intellectual and adaptive functioning based on clinical assessment and as measured by individually administered, appropriately normed, standardized and validated tests of intellectual functioning and adaptive behavior, with onset during the developmental period from infancy through adolescence. Evidence: TAS. Frequency: Frequent (HP:0040282). (ORPHA:487796)
- Abnormal heart morphology (HP:0001627): Any structural anomaly of the heart. Evidence: TAS. Frequency: Frequent (HP:0040282). (ORPHA:487796)
- Thrombocytopenia (HP:0001873): A reduction in the number of circulating thrombocytes. Evidence: TAS. Frequency: Frequent (HP:0040282). (ORPHA:487796)
- Hypoplasia of the corpus callosum (HP:0002079): Underdevelopment of the corpus callosum. Evidence: TAS. Frequency: Frequent (HP:0040282). (ORPHA:487796)
- Ventriculomegaly (HP:0002119): An increase in size of the ventricular system of the brain. Evidence: TAS. Frequency: Frequent (HP:0040282). (ORPHA:487796)
- Abnormal periventricular white matter morphology (HP:0002518): A structural abnormality of the myelinated axons (white matter) located near the cerebral ventricles. Evidence: TAS. Frequency: Frequent (HP:0040282). (ORPHA:487796)
- Scoliosis (HP:0002650): The presence of an abnormal lateral curvature of the spine. Evidence: TAS. Frequency: Frequent (HP:0040282). (ORPHA:487796)
- Recurrent infections (HP:0002719): Increased susceptibility to infections as manifested by repeated bouts of infection. Evidence: TAS. Frequency: Frequent (HP:0040282). (ORPHA:487796)
- Postnatal growth retardation (HP:0008897): Slow or limited growth after birth. Evidence: TAS. Frequency: Frequent (HP:0040282). (ORPHA:487796)
- Increased mean platelet volume (HP:0011877): Average platelet volume above the upper limit of the normal reference interval. Evidence: TAS. Frequency: Frequent (HP:0040282). (ORPHA:487796)
- Inguinal hernia (HP:0000023): Protrusion of the contents of the abdominal cavity through the inguinal canal. Evidence: TAS. Frequency: Occasional (HP:0040283). (ORPHA:487796)
- Hypospadias (HP:0000047): Abnormal position of urethral meatus on the ventral penile shaft (underside) characterized by displacement of the urethral meatus from the tip of the glans penis to the ventral surface of the penis, scrotum, or perineum. Evidence: TAS. Frequency: Occasional (HP:0040283). (ORPHA:487796)
- Unilateral renal agenesis (HP:0000122): A unilateral form of agenesis of the kidney. Evidence: TAS. Frequency: Occasional (HP:0040283). (ORPHA:487796)
- Hydronephrosis (HP:0000126): Severe distention of the kidney with dilation of the renal pelvis and calices. Evidence: TAS. Frequency: Occasional (HP:0040283). (ORPHA:487796)
- Wide mouth (HP:0000154): Distance between the oral commissures more than 2 SD above the mean. Alternatively, an apparently increased width of the oral aperture (subjective). Evidence: TAS. Frequency: Occasional (HP:0040283). (ORPHA:487796)
- Thin upper lip vermilion (HP:0000219): Height of the vermilion of the upper lip in the midline more than 2 SD below the mean. Alternatively, an apparently reduced height of the vermilion of the upper lip in the frontal view (subjective). Evidence: TAS. Frequency: Occasional (HP:0040283). (ORPHA:487796)
- Microcephaly (HP:0000252): Head circumference below 2 standard deviations below the mean for age and gender. Evidence: TAS. Frequency: Occasional (HP:0040283). (ORPHA:487796)
- Hypertelorism (HP:0000316): Interpupillary distance more than 2 SD above the mean (alternatively, the appearance of an increased interpupillary distance or widely spaced eyes). Evidence: TAS. Frequency: Occasional (HP:0040283). (ORPHA:487796)
- Smooth philtrum (HP:0000319): Flat skin surface, with no ridge formation in the central region of the upper lip between the nasal base and upper vermilion border. Evidence: TAS. Frequency: Occasional (HP:0040283). (ORPHA:487796)
- Short philtrum (HP:0000322): Distance between nasal base and midline upper lip vermilion border more than 2 SD below the mean. Alternatively, an apparently decreased distance between nasal base and midline upper lip vermilion border. Evidence: TAS. Frequency: Occasional (HP:0040283). (ORPHA:487796)
- Narrow forehead (HP:0000341): Width of the forehead or distance between the frontotemporales is more than two standard deviations below the mean (objective); or apparently narrow intertemporal region (subjective). Evidence: TAS. Frequency: Occasional (HP:0040283). (ORPHA:487796)
- Long philtrum (HP:0000343): Distance between nasal base and midline upper lip vermilion border more than 2 SD above the mean. Alternatively, an apparently increased distance between nasal base and midline upper lip vermilion border. Evidence: TAS. Frequency: Occasional (HP:0040283). (ORPHA:487796)
- Posteriorly rotated ears (HP:0000358): A type of abnormal location of the ears in which the position of the ears is characterized by posterior rotation (the superior part of the ears is rotated towards the back of the head, and the inferior part of the ears towards the front). Evidence: TAS. Frequency: Occasional (HP:0040283). (ORPHA:487796)
- Hearing impairment (HP:0000365): A decreased magnitude of the sensory perception of sound. Evidence: TAS. Frequency: Occasional (HP:0040283). (ORPHA:487796)
- Bulbous nose (HP:0000414): Increased volume and globular shape of the anteroinferior aspect of the nose. Evidence: TAS. Frequency: Occasional (HP:0040283). (ORPHA:487796)
- Wide nasal bridge (HP:0000431): Increased breadth of the nasal bridge (and with it, the nasal root). Evidence: TAS. Frequency: Occasional (HP:0040283). (ORPHA:487796)
- Flared nostrils (HP:0000454). Evidence: TAS. Frequency: Occasional (HP:0040283). (ORPHA:487796)
- Webbed neck (HP:0000465): Pterygium colli is a congenital skin fold that runs along the sides of the neck down to the shoulders. It involves an ectopic fibrotic facial band superficial to the trapezius muscle. Excess hair-bearing skin is also present and extends down the cervical region well beyond the normal hairline. Evidence: TAS. Frequency: Occasional (HP:0040283). (ORPHA:487796)
- Strabismus (HP:0000486): A misalignment of the eyes so that the visual axes deviate from bifoveal fixation. The classification of strabismus may be based on a number of features including the relative position of the eyes, whether the deviation is latent or manifest, intermittent or constant, concomitant or otherwise and according to the age of onset and the relevance of any associated refractive error. Evidence: TAS. Frequency: Occasional (HP:0040283). (ORPHA:487796)
- Downslanted palpebral fissures (HP:0000494): The palpebral fissure inclination is more than two standard deviations below the mean. Evidence: TAS. Frequency: Occasional (HP:0040283). (ORPHA:487796)
- Ptosis (HP:0000508): The upper eyelid margin is positioned 3 mm or more lower than usual and covers the superior portion of the iris (objective); or, the upper lid margin obscures at least part of the pupil (subjective). Evidence: TAS. Frequency: Occasional (HP:0040283). (ORPHA:487796)
- Exotropia (HP:0000577): A form of strabismus with one or both eyes deviated outward. Evidence: TAS. Frequency: Occasional (HP:0040283). (ORPHA:487796)
- Upslanted palpebral fissure (HP:0000582): The palpebral fissure inclination is more than two standard deviations above the mean for age (objective); or, the inclination of the palpebral fissure is greater than typical for age. Evidence: TAS. Frequency: Occasional (HP:0040283). (ORPHA:487796)
- Optic atrophy (HP:0000648): Atrophy of the optic nerve. Optic atrophy results from the death of the retinal ganglion cell axons that comprise the optic nerve and manifesting as a pale optic nerve on fundoscopy. Evidence: TAS. Frequency: Occasional (HP:0040283). (ORPHA:487796)
- Synophrys (HP:0000664): Meeting of the medial eyebrows in the midline. Evidence: TAS. Frequency: Occasional (HP:0040283). (ORPHA:487796)
- Widely spaced teeth (HP:0000687): Increased spaces (diastemata) between most of the teeth in the same dental arch. Evidence: TAS. Frequency: Occasional (HP:0040283). (ORPHA:487796)
- Dental malocclusion (HP:0000689): Dental malocclusion refers to an abnormality of the occlusion, or alignment, of the teeth and the way the upper and lower teeth fit together, resulting in overcrowding of teeth or in abnormal bite patterns. Evidence: TAS. Frequency: Occasional (HP:0040283). (ORPHA:487796)
- Abnormality of the skeletal system (HP:0000924): An abnormality of the skeletal system. Evidence: TAS. Frequency: Occasional (HP:0040283). (ORPHA:487796)
- Lymphedema (HP:0001004): Localized fluid retention and tissue swelling caused by a compromised lymphatic system. Evidence: TAS. Frequency: Occasional (HP:0040283). (ORPHA:487796)
- Tapered finger (HP:0001182): The gradual reduction in girth of the finger from proximal to distal. Evidence: TAS. Frequency: Occasional (HP:0040283). (ORPHA:487796)
- Seizure (HP:0001250): A seizure is an intermittent abnormality of nervous system physiology characterized by a transient occurrence of signs and/or symptoms due to abnormal excessive or synchronous neuronal activity in the brain. Evidence: TAS. Frequency: Occasional (HP:0040283). (ORPHA:487796)
- Global developmental delay (HP:0001263): A delay in the achievement of motor or mental milestones in the domains of development of a child, including motor skills, speech and language, cognitive skills, and social and emotional skills. This term should only be used to describe children younger than five years of age. Evidence: TAS. Frequency: Occasional (HP:0040283). (ORPHA:487796)
- Cerebellar atrophy (HP:0001272): Cerebellar atrophy is defined as a cerebellum with initially normal structures, in a posterior fossa with normal size, which displays enlarged fissures (interfolial spaces) in comparison to the foliae secondary to loss of tissue. Cerebellar atrophy implies irreversible loss of tissue and result from an ongoing progressive disease until a final stage is reached or a single injury, e.g. an intoxication or infectious event. Evidence: TAS. Frequency: Occasional (HP:0040283). (ORPHA:487796)
- Dandy-Walker malformation (HP:0001305): A congenital brain malformation typically characterized by incomplete formation of the cerebellar vermis, dilation of the fourth ventricle, and enlargement of the posterior fossa. In layman's terms, Dandy Walker malformation is a cyst in the cerebellum (typically symmetrical) that is involved with the fourth ventricle. This may interfere with the ability to drain cerebrospinal fluid from the brain, resulting in hydrocephalus. Dandy Walker cysts are formed during early embryonic development, while the brain forms. The cyst in the cerebellum typically has several blood vessels running through it connecting to the brain, thereby prohibiting surgical removal. Evidence: TAS. Frequency: Occasional (HP:0040283). (ORPHA:487796)
- Absent speech (HP:0001344): Complete lack of development of speech and language abilities. Evidence: TAS. Frequency: Occasional (HP:0040283). (ORPHA:487796)
- Flexion contracture (HP:0001371): A flexion contracture is a bent (flexed) joint that cannot be straightened actively or passively. It is thus a chronic loss of joint motion due to structural changes in muscle, tendons, ligaments, or skin that prevents normal movement of joints. Evidence: TAS. Frequency: Occasional (HP:0040283). (ORPHA:487796)
- Patent ductus arteriosus (HP:0001643): In utero, the ductus arteriosus (DA) serves to divert ventricular output away from the lungs and toward the placenta by connecting the main pulmonary artery to the descending aorta. A patent ductus arteriosus (PDA) in the first 3 days of life is a physiologic shunt in healthy term and preterm newborn infants, and normally is substantially closed within about 24 hours after bith and completely closed after about three weeks. Failure of physiologcal closure is referred to a persistent or patent ductus arteriosus (PDA). Depending on the degree of left-to-right shunting, PDA can have clinical consequences. Evidence: TAS. Frequency: Occasional (HP:0040283). (ORPHA:487796)
- Overlapping toe (HP:0001845): Describes a foot digit resting on the dorsal surface of an adjacent digit when the foot is at rest. Initially clawing may be dynamic and only noticeable on walking. Over time the plantar plate tears, subluxation occurs at the metatarsophalangeal joint (MTPJ), and the deformity becomes permanent. Evidence: TAS. Frequency: Occasional (HP:0040283). (ORPHA:487796)
- Poor speech (HP:0002465). Evidence: TAS. Frequency: Occasional (HP:0040283). (ORPHA:487796)
- Highly arched eyebrow (HP:0002553): Increased height of the central portion of the eyebrow, forming a crescent, semicircular, or inverted U shape. Evidence: TAS. Frequency: Occasional (HP:0040283). (ORPHA:487796)
- Downturned corners of mouth (HP:0002714): A morphological abnormality of the mouth in which the angle of the mouth is downturned. The oral commissures are positioned inferior to the midline labial fissure. Evidence: TAS. Frequency: Occasional (HP:0040283). (ORPHA:487796)
- Immunodeficiency (HP:0002721): Failure of the immune system to protect the body adequately from infection, due to the absence or insufficiency of some component process or substance. Evidence: TAS. Frequency: Occasional (HP:0040283). (ORPHA:487796)
- Nevus (HP:0003764): A nevus is a type of hamartoma that is a circumscribed stable malformation of the skin. Evidence: TAS. Frequency: Occasional (HP:0040283). (ORPHA:487796)
- Total anomalous pulmonary venous return (HP:0005160): Total anomalous pulmonary venous return refers to a congenital malformation in which all four pulmonary veins do not connect normally to the left atrium, but instead drain abnormally to the right atrium. Evidence: TAS. Frequency: Occasional (HP:0040283). (ORPHA:487796)
- Cerebellar dysplasia (HP:0007033): Cerebellar dysplasia (abnormal growth or development) is defined by abnormal cerebellar foliation, white matter arborization, and gray-white matter junction. Cerebellar dysplasia is a neuroimaging finding that describes abnormalities of both the cerebellar cortex and white matter and is associated with variable neurodevelopmental outcome. Dysplasia may globally involve the cerebellum or affect only one cerebellar hemisphere. In addition, cerebellar dysplasia may be associated with cortical/subcortical cysts. Evidence: TAS. Frequency: Occasional (HP:0040283). (ORPHA:487796)
- Eversion of lateral third of lower eyelids (HP:0007655). Evidence: TAS. Frequency: Occasional (HP:0040283). (ORPHA:487796)
- Reduced visual acuity (HP:0007663). Evidence: TAS. Frequency: Occasional (HP:0040283). (ORPHA:487796)
- Floppy infant (HP:0008947): Floppiness/hypotonia is defined as reduced resistance to passive movement of joints. Physical examination of floppy/hypotonic infants shows head lag, lack of shoulder and elbow muscle contraction on traction response, inability to tighten the shoulder girdle muscles (or slipping through) when held under the axillae, scarf sign (when the arm is pulled to the opposite side, the arm wraps around the neck with the elbow crossing midline), hyperdorsiflexion of the feet, easy apposition of the thumb against the forearm, feet touching the cheek with ease and without discomfort, frog leg position, and inverted U sign on ventral suspension (head, arms, and legs hanging down without elbow or knee flexion and the trunk rounded in a dome shape). Evidence: TAS. Frequency: Occasional (HP:0040283). (ORPHA:487796)
- Proximal placement of thumb (HP:0009623): Proximal mislocalization of the thumb. Evidence: TAS. Frequency: Occasional (HP:0040283). (ORPHA:487796)
- Tented upper lip vermilion (HP:0010804): Triangular appearance of the oral aperture with the apex in the midpoint of the upper vermilion and the lower vermilion forming the base. Evidence: TAS. Frequency: Occasional (HP:0040283). (ORPHA:487796)
- Prominent forehead (HP:0011220): Forward prominence of the entire forehead, due to protrusion of the frontal bone. Evidence: TAS. Frequency: Occasional (HP:0040283). (ORPHA:487796)
- Midface retrusion (HP:0011800): Posterior positions and/or vertical shortening of the infraorbital and perialar regions, or increased concavity of the face and/or reduced nasolabial angle. Evidence: TAS. Frequency: Occasional (HP:0040283). (ORPHA:487796)
- Camptodactyly (HP:0012385): The distal interphalangeal joint and/or the proximal interphalangeal joint of the fingers or toes cannot be extended to 180 degrees by either active or passive extension. Evidence: TAS. Frequency: Occasional (HP:0040283). (ORPHA:487796)
- Clinodactyly (HP:0030084): An angulation of a digit at an interphalangeal joint in the plane of the palm (finger) or sole (toe). Evidence: TAS. Frequency: Occasional (HP:0040283). (ORPHA:487796)
- Sparse eyebrow (HP:0045075): Decreased density/number of eyebrow hairs. Evidence: TAS. Frequency: Occasional (HP:0040283). (ORPHA:487796)
- Abnormality of the lymphatic system (HP:0100763): An anomaly of the lymphatic system, a network of lymphatic vessels that carry a clear fluid called lymph unidirectionally towards either the right lymphatic duct or the thoracic duct, which in turn drain into the right and left subclavian veins respectively. Evidence: TAS. Frequency: Occasional (HP:0040283). (ORPHA:487796)
These phenotypes are associated with the disease Takenouchi-Kosaki syndrome (ORPHA:487796).